Phenotypes associated with the disease reticuloendotheliosis, X-linked (OMIM:312500):
- Anemia (HP:0001903): A reduction in erythrocytes volume or hemoglobin concentration. Evidence: IEA. (OMIM:312500)
- Infantile onset (HP:0003593): Onset of signs or symptoms of disease between 28 days to one year of life. Evidence: IEA. (OMIM:312500)
- Lymphadenopathy (HP:0002716): Enlargement (swelling) of a lymph node. Evidence: IEA. (OMIM:312500)
- X-linked inheritance (HP:0001417): A mode of inheritance that is observed for traits related to a gene encoded on the X chromosome. Evidence: IEA. (OMIM:312500)
- Hepatosplenomegaly (HP:0001433): Simultaneous enlargement of the liver and spleen. Evidence: IEA. (OMIM:312500)
- Jaundice (HP:0000952): Yellow pigmentation of the skin due to bilirubin, which in turn is the result of increased bilirubin concentration in the bloodstream. Evidence: IEA. (OMIM:312500)